Phenotypes associated with the disease Coronary arterial fistula (ORPHA:2041):
- Congestive heart failure (HP:0001635): The presence of an abnormality of cardiac function that is responsible for the failure of the heart to pump blood at a rate that is commensurate with the needs of the tissues or a state in which abnormally elevated filling pressures are required for the heart to do so. Heart failure is frequently related to a defect in myocardial contraction. Evidence: TAS. Frequency: Frequent (HP:0040282). (ORPHA:2041)
- Cardiomegaly (HP:0001640): Increased size of the heart, clinically defined as an increased transverse diameter of the cardiac silhouette that is greater than or equal to 50% of the transverse diameter of the chest (increased cardiothoracic ratio) on a posterior-anterior projection of a chest radiograph or a computed tomography. Evidence: TAS. Frequency: Frequent (HP:0040282). (ORPHA:2041)
- Tachycardia (HP:0001649): A rapid heartrate that exceeds the range of the normal resting heartrate for age. Evidence: TAS. Frequency: Frequent (HP:0040282). (ORPHA:2041)
- Exertional dyspnea (HP:0002875): Perceived difficulty to breathe that occurs with exercise or exertion and improves with rest. Evidence: TAS. Frequency: Frequent (HP:0040282). (ORPHA:2041)
- Abnormal EKG (HP:0003115): Abnormal rhythm of the heart. Evidence: TAS. Frequency: Frequent (HP:0040282). (ORPHA:2041)
- Abnormal left ventricular function (HP:0005162): Inability of the left ventricle to perform its normal physiologic function. Failure is either due to an inability to contract the left ventricle or the inability to relax completely and fill with blood during diastole. Evidence: TAS. Frequency: Frequent (HP:0040282). (ORPHA:2041)
- Systolic heart murmur (HP:0031664): A heart murmur limited to systole, i.e., between the first and second heart sounds S1 and S2. Evidence: TAS. Frequency: Frequent (HP:0040282). (ORPHA:2041)
- Continuous heart murmur (HP:0031670): A murmur that occurs in both systole and diastole. Evidence: TAS. Frequency: Frequent (HP:0040282). (ORPHA:2041)
- Syncope (HP:0001279): A transient loss of consciousness (i.e., characterized by a rapid onset, a short duration, and a spontaneous and complete recovery) due to cerebral hypoperfusion. Evidence: TAS. Frequency: Occasional (HP:0040283). (ORPHA:2041)
- Abnormal heart morphology (HP:0001627): Any structural anomaly of the heart. Evidence: TAS. Frequency: Occasional (HP:0040283). (ORPHA:2041)
- Atrial septal defect (HP:0001631): Atrial septal defect (ASD) is a congenital abnormality of the interatrial septum that enables blood flow between the left and right atria via the interatrial septum. Evidence: TAS. Frequency: Occasional (HP:0040283). (ORPHA:2041)
- Patent ductus arteriosus (HP:0001643): In utero, the ductus arteriosus (DA) serves to divert ventricular output away from the lungs and toward the placenta by connecting the main pulmonary artery to the descending aorta. A patent ductus arteriosus (PDA) in the first 3 days of life is a physiologic shunt in healthy term and preterm newborn infants, and normally is substantially closed within about 24 hours after bith and completely closed after about three weeks. Failure of physiologcal closure is referred to a persistent or patent ductus arteriosus (PDA). Depending on the degree of left-to-right shunting, PDA can have clinical consequences. Evidence: TAS. Frequency: Occasional (HP:0040283). (ORPHA:2041)
- Bicuspid aortic valve (HP:0001647): The presence of an aortic valve with two instead of the normal three cusps (flaps). Bicuspid aortic valvue is a malformation of a commissure (small space between the attachment of each cusp to the aortic wall) and the adjacent parts of the two corresponding cusps forming a raphe (the fused area of the two underdeveloped cusps turning into a malformed commissure between both cusps; the raphe is a fibrous ridge that extends from the commissure to the free edge of the two underdeveloped, conjoint cusps). Evidence: TAS. Frequency: Occasional (HP:0040283). (ORPHA:2041)
- Aortic valve stenosis (HP:0001650): The presence of a stenosis (narrowing) of the aortic valve. Evidence: TAS. Frequency: Occasional (HP:0040283). (ORPHA:2041)
- Patent foramen ovale (HP:0001655): Failure of the foramen ovale to seal postnatally, leaving a potential conduit between the left and right cardiac atria. Evidence: TAS. Frequency: Occasional (HP:0040283). (ORPHA:2041)
- Angina pectoris (HP:0001681): Paroxysmal chest pain that occurs with exertion or stress and is related to myocardial ischemia. Evidence: TAS. Frequency: Occasional (HP:0040283). (ORPHA:2041)
- Palpitations (HP:0001962): A sensation that the heart is pounding or racing, which is a non-specific sign but may be a manifestation of arrhythmia. Evidence: TAS. Frequency: Occasional (HP:0040283). (ORPHA:2041)
- Pulmonary arterial hypertension (HP:0002092): Pulmonary hypertension is defined mean pulmonary artery pressure of 25mmHg or more and pulmonary capillary wedge pressure of 15mmHg or less when measured by right heart catheterisation at rest and in a supine position. Evidence: TAS. Frequency: Occasional (HP:0040283). (ORPHA:2041)
- Vascular dilatation (HP:0002617): An abnormal increase in the diameter of an artery or vein, either as a diffuse dilatation or as a localized, sac-like outpouching of the vessel wall (aneurysm). Evidence: TAS. Frequency: Occasional (HP:0040283). (ORPHA:2041)
- Tachypnea (HP:0002789): Very rapid breathing. Evidence: TAS. Frequency: Occasional (HP:0040283). (ORPHA:2041)
- Right ventricular dilatation (HP:0005133): Enlargement of the chamber of the right ventricle, which can be defined echocardiographically as a right ventricular to left ventricular ratio greater than 1:1. Evidence: TAS. Frequency: Occasional (HP:0040283). (ORPHA:2041)
- Bacterial endocarditis (HP:0006689): A bacterial infection of the endocardium, the inner layer of the heart, which usually involves the heart valves. Evidence: TAS. Frequency: Occasional (HP:0040283). (ORPHA:2041)
- Pedal edema (HP:0010741): An abnormal accumulation of excess fluid in the lower extremity resulting in swelling of the feet and extending upward to the lower leg. Evidence: TAS. Frequency: Occasional (HP:0040283). (ORPHA:2041)
- Arrhythmia (HP:0011675): Any cardiac rhythm other than the normal sinus rhythm. Such a rhythm may be either of sinus or ectopic origin and either regular or irregular. An arrhythmia may be due to a disturbance in impulse formation or conduction or both. Evidence: TAS. Frequency: Occasional (HP:0040283). (ORPHA:2041)
- Orthopnea (HP:0012764): A sensation of breathlessness in the recumbent position, relieved by sitting or standing. Evidence: TAS. Frequency: Occasional (HP:0040283). (ORPHA:2041)
- Elevated jugular venous pressure (HP:0030848): Increased jugular venous pressure. Evidence: TAS. Frequency: Occasional (HP:0040283). (ORPHA:2041)
- Coronary artery aneurysm (HP:0030882): Enlargement of the diameter (cross-section) of a coronary artery as defined by a focal dilation of a segment at least 1.5 times larger than the reference vessel. Evidence: TAS. Frequency: Occasional (HP:0040283). (ORPHA:2041)